Phenotypes associated with the disease cleft larynx, posterior (OMIM:215800):
- Abnormality of the voice (HP:0001608). Evidence: IEA. (OMIM:215800)
- Autosomal recessive inheritance (HP:0000007): A mode of inheritance that is observed for traits related to a gene encoded on one of the autosomes (i.e., the human chromosomes 1-22) in which a trait manifests in individuals with two pathogenic alleles, either homozygotes (two copies of the same mutant allele) or compound heterozygotes (whereby each copy of a gene has a distinct mutant allele). Evidence: TAS. (OMIM:215800)
- Aspiration (HP:0002835): Inspiration of a foreign object into the airway. Evidence: IEA. (OMIM:215800)
- Cyanosis (HP:0000961): Bluish discoloration of the skin and mucosa due to poor circulation or inadequate oxygenation of arterial or capillary blood. Evidence: IEA. (OMIM:215800)
- Laryngeal stridor (HP:0006511): An abnormal high-pitched noisy sound, occurring during inhalation or exhalation caused by the incomplete obstruction in the throat. Evidence: IEA. (OMIM:215800)